- Opacification of the corneal stroma (HP:0007759): Reduced transparency of the stroma of cornea. Evidence: PCS. Frequency: 6/6. (PMID:17661825)
- Congenital onset (HP:0003577): A phenotypic abnormality that is present at birth. Evidence: PCS. Frequency: 6/6. (PMID:17661825)
- Microphthalmia (HP:0000568): A developmental anomaly characterized by abnormal smallness of one or both eyes. Evidence: PCS. Frequency: 6/6. (PMID:17661825)
- Autosomal recessive inheritance (HP:0000007): A mode of inheritance that is observed for traits related to a gene encoded on one of the autosomes (i.e., the human chromosomes 1-22) in which a trait manifests in individuals with two pathogenic alleles, either homozygotes (two copies of the same mutant allele) or compound heterozygotes (whereby each copy of a gene has a distinct mutant allele). Evidence: PCS. (PMID:17661825)
- Intellectual disability (HP:0001249): The term intellectual disability or intellectual developmental disorder is used to describe significantly sub-average intellectual and adaptive functioning based on clinical assessment and as measured by individually administered, appropriately normed, standardized and validated tests of intellectual functioning and adaptive behavior, with onset during the developmental period from infancy through adolescence. Evidence: PCS. Frequency: 0/6. (PMID:17661825)
These phenotypes are associated with the disease isolated microphthalmia 2 (OMIM:610093).